Phenotypes associated with the disease Moderate multiminicore disease with hand involvement (ORPHA:178145):
- Neonatal hypotonia (HP:0001319): Muscular hypotonia (abnormally low muscle tone) manifesting in the neonatal period. Evidence: TAS. Frequency: Frequent (HP:0040282). (ORPHA:178145)
- Joint hypermobility (HP:0001382): The capability that a joint (or a group of joints) has to move, passively and/or actively, beyond normal limits along physiological axes. Evidence: TAS. Frequency: Frequent (HP:0040282). (ORPHA:178145)
- Talipes equinovarus (HP:0001762): Talipes equinovarus (also called clubfoot) typically has four main components: inversion and adduction of the forefoot; inversion of the heel and hindfoot; equinus (limitation of extension) of the ankle and subtalar joint; and internal rotation of the leg. Evidence: TAS. Frequency: Frequent (HP:0040282). (ORPHA:178145)
- Delayed gross motor development (HP:0002194): A type of motor delay characterized by a delay in acquiring the ability to control the large muscles of the body for walking, running, sitting, and crawling. Evidence: TAS. Frequency: Frequent (HP:0040282). (ORPHA:178145)
- Generalized muscle weakness (HP:0003324): Generalized weakness or decreased strength of the muscles, affecting both distal and proximal musculature. Evidence: TAS. Frequency: Frequent (HP:0040282). (ORPHA:178145)
- Axial muscle weakness (HP:0003327): Reduced strength of the axial musculature (i.e., of the muscles of the head and neck, spine, and ribs). Evidence: TAS. Frequency: Frequent (HP:0040282). (ORPHA:178145)
- Intrinsic hand muscle atrophy (HP:0008954): Atrophy of the intrinsic muscle groups of the hand, comprising the thenar and hypothenar muscles; the interossei muscles; and the lumbrical muscles. Evidence: TAS. Frequency: Frequent (HP:0040282). (ORPHA:178145)
- Distal upper limb muscle weakness (HP:0008959): Reduced strength of the distal musculature of the arms. Evidence: TAS. Frequency: Frequent (HP:0040282). (ORPHA:178145)
- Difficulty running (HP:0009046): Reduced ability to run. Evidence: TAS. Frequency: Frequent (HP:0040282). (ORPHA:178145)
- Facial palsy (HP:0010628): Facial nerve palsy is a dysfunction of cranial nerve VII (the facial nerve) that results in inability to control facial muscles on the affected side with weakness of the muscles of facial expression and eye closure. This can either be present in unilateral or bilateral form. Evidence: TAS. Frequency: Frequent (HP:0040282). (ORPHA:178145)
- Hyporeflexia of upper limbs (HP:0012391): Reduced intensity of muscle tendon reflexes in the upper limbs. Reflexes are elicited by stretching the tendon of a muscle, e.g., by tapping. Evidence: TAS. Frequency: Frequent (HP:0040282). (ORPHA:178145)
- Type 1 muscle fiber predominance (HP:0003803): An abnormal predominance of type I muscle fibers (in general, this feature can only be observed on muscle biopsy). Evidence: TAS. Frequency: Occasional (HP:0040283). (ORPHA:178145)
- Knee dislocation (HP:0004976). Evidence: TAS. Frequency: Occasional (HP:0040283). (ORPHA:178145)
- Recurrent patellar dislocation (HP:0005001): Patellar dislocation occurring repeated times. Evidence: TAS. Frequency: Occasional (HP:0040283). (ORPHA:178145)